Phenotypes associated with the disease autosomal recessive nonsyndromic hearing loss 1B (OMIM:612645):
- Abnormal vestibular function (HP:0001751): An abnormality of the functioning of the vestibular apparatus. Evidence: TAS. Frequency: Occasional (HP:0040283). (OMIM:612645)
- Hearing impairment (HP:0000365): A decreased magnitude of the sensory perception of sound. Evidence: IEA. (OMIM:612645)
- Autosomal recessive inheritance (HP:0000007): A mode of inheritance that is observed for traits related to a gene encoded on one of the autosomes (i.e., the human chromosomes 1-22) in which a trait manifests in individuals with two pathogenic alleles, either homozygotes (two copies of the same mutant allele) or compound heterozygotes (whereby each copy of a gene has a distinct mutant allele). Evidence: TAS. (OMIM:612645)